- Seizure (HP:0001250): A seizure is an intermittent abnormality of nervous system physiology characterized by a transient occurrence of signs and/or symptoms due to abnormal excessive or synchronous neuronal activity in the brain. Evidence: PCS. Frequency: Occasional (HP:0040283). (PMID:19377476)
- X-linked recessive inheritance (HP:0001419): A mode of inheritance that is observed for recessive traits related to a gene encoded on the X chromosome. In the context of medical genetics, X-linked recessive disorders manifest in males (who have one copy of the X chromosome and are thus hemizygotes), but generally not in female heterozygotes who have one mutant and one normal allele. Evidence: PCS. (PMID:19377476)
- Intellectual disability (HP:0001249): The term intellectual disability or intellectual developmental disorder is used to describe significantly sub-average intellectual and adaptive functioning based on clinical assessment and as measured by individually administered, appropriately normed, standardized and validated tests of intellectual functioning and adaptive behavior, with onset during the developmental period from infancy through adolescence. Evidence: PCS. Frequency: 3/3. (PMID:19377476)
These phenotypes are associated with the disease intellectual disability, X-linked 96 (OMIM:300802).